Phenotypes associated with the disease 3-phosphoserine phosphatase deficiency, infantile/juvenile form (ORPHA:79350):
- Global developmental delay (HP:0001263): A delay in the achievement of motor or mental milestones in the domains of development of a child, including motor skills, speech and language, cognitive skills, and social and emotional skills. This term should only be used to describe children younger than five years of age. Evidence: TAS. Frequency: Frequent (HP:0040282). (ORPHA:79350)
- Moderate intellectual disability (HP:0002342): Moderate intellectual disability (ID) is defined as a type of ID characterized by moderately sub-average adaptive functioning and intellectual functioning, with an intelligence quotient (IQ) the range of 35-49. Evidence: TAS. Frequency: Frequent (HP:0040282). (ORPHA:79350)
- Postnatal growth retardation (HP:0008897): Slow or limited growth after birth. Evidence: TAS. Frequency: Frequent (HP:0040282). (ORPHA:79350)
- Feeding difficulties (HP:0011968): Impaired ability to eat related to problems gathering food and getting ready to suck, chew, or swallow it. Evidence: TAS. Frequency: Frequent (HP:0040282). (ORPHA:79350)
- Hyposerinemia (HP:0012279): Reduced concentration of serine in the blood. Evidence: TAS. Frequency: Frequent (HP:0040282). (ORPHA:79350)
- Hypospadias (HP:0000047): Abnormal position of urethral meatus on the ventral penile shaft (underside) characterized by displacement of the urethral meatus from the tip of the glans penis to the ventral surface of the penis, scrotum, or perineum. Evidence: TAS. Frequency: Occasional (HP:0040283). (ORPHA:79350)
- Wide mouth (HP:0000154): Distance between the oral commissures more than 2 SD above the mean. Alternatively, an apparently increased width of the oral aperture (subjective). Evidence: TAS. Frequency: Occasional (HP:0040283). (ORPHA:79350)
- Microcephaly (HP:0000252): Head circumference below 2 standard deviations below the mean for age and gender. Evidence: TAS. Frequency: Occasional (HP:0040283). (ORPHA:79350)
- Full cheeks (HP:0000293): Increased prominence or roundness of soft tissues between zygomata and mandible. Evidence: TAS. Frequency: Occasional (HP:0040283). (ORPHA:79350)
- Broad forehead (HP:0000337): Width of the forehead or distance between the frontotemporales is more than two standard deviations above the mean (objective); or apparently increased distance between the two sides of the forehead. Evidence: TAS. Frequency: Occasional (HP:0040283). (ORPHA:79350)
- Narrow forehead (HP:0000341): Width of the forehead or distance between the frontotemporales is more than two standard deviations below the mean (objective); or apparently narrow intertemporal region (subjective). Evidence: TAS. Frequency: Occasional (HP:0040283). (ORPHA:79350)
- Micrognathia (HP:0000347): Developmental hypoplasia of the mandible. Evidence: TAS. Frequency: Occasional (HP:0040283). (ORPHA:79350)
- Hypertonia (HP:0001276): A condition in which there is increased muscle tone so that arms or legs, for example, are stiff and difficult to move. Evidence: TAS. Frequency: Occasional (HP:0040283). (ORPHA:79350)
- Abnormal facial shape (HP:0001999): An abnormal morphology (form) of the face or its components. Evidence: TAS. Frequency: Occasional (HP:0040283). (ORPHA:79350)
- Gastroesophageal reflux (HP:0002020): A condition in which the stomach contents leak backwards from the stomach into the esophagus through the lower esophageal sphincter. Evidence: TAS. Frequency: Occasional (HP:0040283). (ORPHA:79350)
- Bilateral tonic-clonic seizure (HP:0002069): A bilateral tonic-clonic seizure is a seizure defined by a tonic (bilateral increased tone, lasting seconds to minutes) and then a clonic (bilateral sustained rhythmic jerking) phase. Evidence: TAS. Frequency: Occasional (HP:0040283). (ORPHA:79350)
- Palpebral edema (HP:0100540): Edema in the region of the eyelids. Evidence: TAS. Frequency: Occasional (HP:0040283). (ORPHA:79350)
- Esophagitis (HP:0100633): Inflammation of the esophagus. Evidence: TAS. Frequency: Occasional (HP:0040283). (ORPHA:79350)